- Decreased circulating LDL-C concentration (HP:0003563): The concentration of low-density lipoprotein cholesterol in the blood circulation is below the lower limit of normal. Evidence: PCS. (PMID:20942659)
- Hypotriglyceridemia (HP:0012153): An decrease in the level of triglycerides in the blood. Evidence: PCS. (PMID:20942659)
- Autosomal recessive inheritance (HP:0000007): A mode of inheritance that is observed for traits related to a gene encoded on one of the autosomes (i.e., the human chromosomes 1-22) in which a trait manifests in individuals with two pathogenic alleles, either homozygotes (two copies of the same mutant allele) or compound heterozygotes (whereby each copy of a gene has a distinct mutant allele). Evidence: PCS. (PMID:20942659)
These phenotypes are associated with the disease familial hypobetalipoproteinemia 2 (OMIM:605019).